Phenotypes associated with the disease Severe neonatal hypotonia-seizures-encephalopathy syndrome due to 5q31.3 microdeletion (ORPHA:314655):
- High palate (HP:0000218): Height of the palate more than 2 SD above the mean (objective) or palatal height at the level of the first permanent molar more than twice the height of the teeth (subjective). Evidence: TAS. Frequency: Frequent (HP:0040282). (ORPHA:314655)
- Narrow forehead (HP:0000341): Width of the forehead or distance between the frontotemporales is more than two standard deviations below the mean (objective); or apparently narrow intertemporal region (subjective). Evidence: TAS. Frequency: Frequent (HP:0040282). (ORPHA:314655)
- Micrognathia (HP:0000347): Developmental hypoplasia of the mandible. Evidence: TAS. Frequency: Frequent (HP:0040282). (ORPHA:314655)
- Telecanthus (HP:0000506): Distance between the inner canthi more than two standard deviations above the mean (objective); or, apparently increased distance between the inner canthi. Evidence: TAS. Frequency: Frequent (HP:0040282). (ORPHA:314655)
- Ptosis (HP:0000508): The upper eyelid margin is positioned 3 mm or more lower than usual and covers the superior portion of the iris (objective); or, the upper lid margin obscures at least part of the pupil (subjective). Evidence: TAS. Frequency: Frequent (HP:0040282). (ORPHA:314655)
- Delayed speech and language development (HP:0000750): A degree of language development that is significantly below the norm for a child of a specified age. Evidence: TAS. Frequency: Frequent (HP:0040282). (ORPHA:314655)
- Motor delay (HP:0001270): A type of Developmental delay characterized by a delay in acquiring motor skills. Evidence: TAS. Frequency: Frequent (HP:0040282). (ORPHA:314655)
- Neonatal hypotonia (HP:0001319): Muscular hypotonia (abnormally low muscle tone) manifesting in the neonatal period. Evidence: TAS. Frequency: Frequent (HP:0040282). (ORPHA:314655)
- Deep philtrum (HP:0002002): Accentuated, prominent philtral ridges giving rise to an exaggerated groove in the midline between the nasal base and upper vermillion border. Evidence: TAS. Frequency: Frequent (HP:0040282). (ORPHA:314655)
- Respiratory distress (HP:0002098): Respiratory distress is objectively observable as the physical or emotional consequences from the experience of dyspnea. The physical presentation of respiratory distress is generally referred to as labored breathing, while the sensation of respiratory distress is called shortness of breath or dyspnea. Evidence: TAS. Frequency: Frequent (HP:0040282). (ORPHA:314655)
- EEG abnormality (HP:0002353): Abnormality observed by electroencephalogram (EEG), which is used to record of the brain's spontaneous electrical activity from multiple electrodes placed on the scalp. Evidence: TAS. Frequency: Frequent (HP:0040282). (ORPHA:314655)
- Depressed nasal bridge (HP:0005280): Posterior positioning of the nasal root in relation to the overall facial profile for age. Evidence: TAS. Frequency: Frequent (HP:0040282). (ORPHA:314655)
- Sparse lateral eyebrow (HP:0005338): Decreased density/number and/or decreased diameter of lateral eyebrow hairs. Evidence: TAS. Frequency: Frequent (HP:0040282). (ORPHA:314655)
- Prominent metopic ridge (HP:0005487): Vertical bony ridge positioned in the midline of the forehead. Evidence: TAS. Frequency: Frequent (HP:0040282). (ORPHA:314655)
- Feeding difficulties in infancy (HP:0008872): Impaired feeding performance of an infant as manifested by difficulties such as weak and ineffective sucking, brief bursts of sucking, and falling asleep during sucking. There may be difficulties with chewing or maintaining attention. Evidence: TAS. Frequency: Frequent (HP:0040282). (ORPHA:314655)
- Tented upper lip vermilion (HP:0010804): Triangular appearance of the oral aperture with the apex in the midpoint of the upper vermilion and the lower vermilion forming the base. Evidence: TAS. Frequency: Frequent (HP:0040282). (ORPHA:314655)
- Severe intellectual disability (HP:0010864): Severe intellectual disability (ID) is defined as a type of ID characterized by severely sub-average adaptive functioning and intellectual functioning, with an intelligence quotient (IQ) the range of 20-34. Evidence: TAS. Frequency: Frequent (HP:0040282). (ORPHA:314655)
- Brain atrophy (HP:0012444): Partial or complete wasting (loss) of brain tissue that was once present. Evidence: TAS. Frequency: Frequent (HP:0040282). (ORPHA:314655)
- Delayed myelination (HP:0012448): Delayed myelination. Evidence: TAS. Frequency: Frequent (HP:0040282). (ORPHA:314655)
- Brain imaging abnormality (HP:0410263): An anomaly of metabolism or structure of the brain identified by imaging. Evidence: TAS. Frequency: Frequent (HP:0040282). (ORPHA:314655)
- Low-set ears (HP:0000369): Upper insertion of the ear to the scalp below an imaginary horizontal line drawn between the inner canthi of the eye and extending posteriorly to the ear. Evidence: TAS. Frequency: Occasional (HP:0040283). (ORPHA:314655)
- Anteverted nares (HP:0000463): Anteriorly-facing nostrils viewed with the head in the Frankfurt horizontal and the eyes of the observer level with the eyes of the subject. This gives the appearance of an upturned nose (upturned nasal tip). Evidence: TAS. Frequency: Occasional (HP:0040283). (ORPHA:314655)
- Downslanted palpebral fissures (HP:0000494): The palpebral fissure inclination is more than two standard deviations below the mean. Evidence: TAS. Frequency: Occasional (HP:0040283). (ORPHA:314655)
- Seizure (HP:0001250): A seizure is an intermittent abnormality of nervous system physiology characterized by a transient occurrence of signs and/or symptoms due to abnormal excessive or synchronous neuronal activity in the brain. Evidence: TAS. Frequency: Occasional (HP:0040283). (ORPHA:314655)
- Myoclonus (HP:0001336): Very brief, involuntary random muscular contractions occurring at rest, in response to sensory stimuli, or accompanying voluntary movements. Evidence: TAS. Frequency: Occasional (HP:0040283). (ORPHA:314655)
- Abnormal heart morphology (HP:0001627): Any structural anomaly of the heart. Evidence: TAS. Frequency: Occasional (HP:0040283). (ORPHA:314655)
- Apnea (HP:0002104): Lack of breathing with no movement of the respiratory muscles and no exchange of air in the lungs. This term refers to a disposition to have recurrent episodes of apnea rather than to a single event. Evidence: TAS. Frequency: Occasional (HP:0040283). (ORPHA:314655)
- Hypoventilation (HP:0002791): A reduction in the amount of air transported into the pulmonary alveoli by breathing, leading to hypercapnia (increase in the partial pressure of carbon dioxide). Evidence: TAS. Frequency: Occasional (HP:0040283). (ORPHA:314655)
- Short nose (HP:0003196): Distance from nasion to subnasale more than two standard deviations below the mean, or alternatively, an apparently decreased length from the nasal root to the nasal tip. Evidence: TAS. Frequency: Occasional (HP:0040283). (ORPHA:314655)
- Recurrent pneumonia (HP:0006532): An increased susceptibility to pneumonia as manifested by a history of recurrent episodes of pneumonia. Evidence: TAS. Frequency: Occasional (HP:0040283). (ORPHA:314655)
- Severe muscular hypotonia (HP:0006829): A severe degree of muscular hypotonia characterized by markedly reduced muscle tone. Evidence: TAS. Frequency: Occasional (HP:0040283). (ORPHA:314655)
- Polydactyly (HP:0010442): A congenital anomaly characterized by the presence of supernumerary fingers or toes. Evidence: TAS. Frequency: Occasional (HP:0040283). (ORPHA:314655)
- Epileptic spasm (HP:0011097): A sudden flexion, extension, or mixed extension-flexion of predominantly proximal and truncal muscles that is usually more sustained than a myoclonic movement but not as sustained as a tonic seizure. Limited forms may occur: Grimacing, head nodding, or subtle eye movements. Epileptic spasms frequently occur in clusters. Infantile spasms are the best known form, but spasms can occur at all ages. Evidence: TAS. Frequency: Occasional (HP:0040283). (ORPHA:314655)
- Speech apraxia (HP:0011098): A type of apraxia that is characterized by difficulty or inability to execute speech movements because of problems with coordination and motor problems, leading to incorrect articulation. An increase of errors with increasing word and phrase length may occur. Evidence: TAS. Frequency: Occasional (HP:0040283). (ORPHA:314655)
- Focal tonic seizure (HP:0011167): A type of focal motor seizure characterized by sustained increase in muscle contraction, lasting a few seconds to minutes. Evidence: TAS. Frequency: Occasional (HP:0040283). (ORPHA:314655)
- Aspiration pneumonia (HP:0011951): Pneumonia due to the aspiration (breathing in) of food, liquid, or gastric contents into the upper respiratory tract. Evidence: TAS. Frequency: Occasional (HP:0040283). (ORPHA:314655)
- Bilateral tonic-clonic seizure with generalized onset (HP:0025190): A bilateral tonic-clonic seizure with generalized onset is a type of bilateral tonic-clonic seizure characterized by generalized onset; these seizures rapidly engage networks in both hemispheres at the start of the seizure. Evidence: TAS. Frequency: Occasional (HP:0040283). (ORPHA:314655)